Phenotypes associated with the disease methemoglobinemia, alpha type (OMIM:617973):
- Congenital onset (HP:0003577): A phenotypic abnormality that is present at birth. Evidence: PCS. (PMID:33251782)
- Methemoglobinemia (HP:0012119): Abnormally increased levels of methemoglobin in the blood. In this form of hemoglobin, there is an oxidized ferric iron (Fe +3) rather than the reduced ferrous form (Fe 2+) that is normally found in hemoglobin. Methemoglobin has a reduced affinity for oxygen, resulting in a reduced ability to release oxygen to tissues. Evidence: PCS. (PMID:33251782)
- Cyanosis (HP:0000961): Bluish discoloration of the skin and mucosa due to poor circulation or inadequate oxygenation of arterial or capillary blood. Evidence: PCS. (PMID:33251782)
- Autosomal dominant inheritance (HP:0000006): A mode of inheritance that is observed for traits related to a gene encoded on one of the autosomes (i.e., the human chromosomes 1-22) in which a trait manifests in heterozygotes. In the context of medical genetics, an autosomal dominant disorder is caused when a single copy of the mutant allele is present. Males and females are affected equally, and can both transmit the disorder with a risk of 50% for each child of inheriting the mutant allele. Evidence: PCS. (PMID:33251782)